Phenotypes associated with the disease Myoclonus-dystonia syndrome (ORPHA:36899):
- Dystonia (HP:0001332): An abnormally increased muscular tone that causes fixed abnormal postures. There is a slow, intermittent twisting motion that leads to exaggerated turning and posture of the extremities and trunk. Evidence: TAS. Frequency: Very frequent (HP:0040281). (ORPHA:36899)
- Myoclonus (HP:0001336): Very brief, involuntary random muscular contractions occurring at rest, in response to sensory stimuli, or accompanying voluntary movements. Evidence: TAS. Frequency: Very frequent (HP:0040281). (ORPHA:36899)
- Spinal myoclonus (HP:0010531): Spinal myoclonus is generally due to a tumor, infection, injury, or degenerative process of the spinal cord, and is characterized by involuntary rhythmic muscle contractions, usually at a rate of more than one per second. Myoclonus occurs synchronously in several muscles and can be increased in severity and frequency by fatigue or stress, but is usually unaffected by sensory stimuli. Spinal myoclonus ceases during sleep or anesthesia. Evidence: TAS. Frequency: Very frequent (HP:0040281). (ORPHA:36899)
- Limb myoclonus (HP:0045084). Evidence: TAS. Frequency: Very frequent (HP:0040281). (ORPHA:36899)
- Torticollis (HP:0000473): Involuntary contractions of the neck musculature resulting in an abnormal posture of or abnormal movements of the head. Evidence: TAS. Frequency: Frequent (HP:0040282). (ORPHA:36899)
- Depression (HP:0000716): Frequently experiencing feelings of being down, miserable, and/or hopeless; struggling to recover from these moods; having a pessimistic outlook on the future; feeling a pervasive sense of shame; having a low self-worth; experiencing thoughts of suicide and engaging in suicidal behavior. Evidence: TAS. Frequency: Frequent (HP:0040282). (ORPHA:36899)
- Compulsive behaviors (HP:0000722): Behavior that consists of repetitive acts, characterized by the feeling that one "has to" perform them, while being aware that these acts are not in line with one's overall goal. Evidence: TAS. Frequency: Frequent (HP:0040282). (ORPHA:36899)
- Anxiety (HP:0000739): Intense feelings of nervousness, tension, or panic often arise in response to interpersonal stresses. There is worry about the negative effects of past unpleasant experiences and future negative possibilities. Individuals may feel fearful, apprehensive, or threatened by uncertainty, and they may also have fears of falling apart or losing control. Evidence: TAS. Frequency: Frequent (HP:0040282). (ORPHA:36899)
- Writer's cramp (HP:0002356): A focal dystonia of the fingers, hand, and/or forearm that appears when the affected person attempts to do a task that requires fine motor movements such as writing or playing a musical instrument. Evidence: TAS. Frequency: Frequent (HP:0040282). (ORPHA:36899)
- Personality disorder (HP:0012075): A personality disorder is a deeply ingrained pattern of behavior of a specified kind that deviates markedly from the norms of generally accepted behavior. It is typically apparent by the time of adolescence and causes long-term difficulties in personal relationships or functioning in society. Evidence: TAS. Frequency: Frequent (HP:0040282). (ORPHA:36899)
- Panic attack (HP:0025269): A sudden episode of intense fear in a situation where there is no danger or apparent cause. Evidence: TAS. Frequency: Frequent (HP:0040282). (ORPHA:36899)